- Anti-CASPR2 (HP:5000005): The presence of autoantibodies (immunoglobulins) in the blood circulation that react against contactin-associated protein-like 2 (CASPR2). Evidence: TAS. Frequency: Frequent (HP:0040282). (ORPHA:83467)
This phenotype is associated with the disease Morvan syndrome (ORPHA:83467).